- Ankyloglossia (HP:0010296): Short or anteriorly attached lingual frenulum, associated with limited mobility of the tongue. Evidence: IEA. (OMIM:106280)
- Supernumerary tooth (HP:0011069): The presence of one or more teeth additional to the normal number. Evidence: IEA. Frequency: Very rare (HP:0040284). (OMIM:106280)
- Autosomal dominant inheritance (HP:0000006): A mode of inheritance that is observed for traits related to a gene encoded on one of the autosomes (i.e., the human chromosomes 1-22) in which a trait manifests in heterozygotes. In the context of medical genetics, an autosomal dominant disorder is caused when a single copy of the mutant allele is present. Males and females are affected equally, and can both transmit the disorder with a risk of 50% for each child of inheriting the mutant allele. Evidence: IEA. (OMIM:106280)
These phenotypes are associated with the disease ankyloglossia (OMIM:106280).